- Reduced social responsiveness (HP:0012760): A reduced ability to participate in the back-and-forth flow of social interaction appropriate to culture and developmental level, which is normally characterized by an influence of the behavior of one person on the behavior of another person. This results in difficulty interacting with others through emotional, physical, or verbal communication. Evidence: TAS. Frequency: Occasional (HP:0040283). (ORPHA:2828)
- Rigidity (HP:0002063): Continuous involuntary sustained muscle contraction. When an affected muscle is passively stretched, the degree of resistance remains constant regardless of the rate at which the muscle is stretched. This feature helps to distinguish rigidity from muscle spasticity. Evidence: TAS. Frequency: Very frequent (HP:0040281). (ORPHA:2828)
- Depression (HP:0000716): Frequently experiencing feelings of being down, miserable, and/or hopeless; struggling to recover from these moods; having a pessimistic outlook on the future; feeling a pervasive sense of shame; having a low self-worth; experiencing thoughts of suicide and engaging in suicidal behavior. Evidence: TAS. Frequency: Frequent (HP:0040282). (ORPHA:2828)
- Hallucinations (HP:0000738): Perceptions in a conscious and awake state that, in the absence of external stimuli, have qualities of real perception. These perceptions are vivid, substantial, and located in external objective space. Evidence: TAS. Frequency: Frequent (HP:0040282). (ORPHA:2828)
- Apathy (HP:0000741): Apathy is a quantitative reduction of interest, motivation and the initiation and persistence of goal-directed behavior, where often the accompanying emotions, thoughts, and social interactions are also diminished. The individual is typically non-reactive to provocations, positive or negative, and appears to not care. Distinguished from lethargy which involves lack of physical or mental energy. Evidence: TAS. Frequency: Frequent (HP:0040282). (ORPHA:2828)
- Tremor (HP:0001337): An unintentional, oscillating to-and-fro muscle movement about a joint axis. Evidence: TAS. Frequency: Frequent (HP:0040282). (ORPHA:2828)
- Postural instability (HP:0002172): A tendency to fall or the inability to keep oneself from falling; imbalance. The retropulsion test is widely regarded as the gold standard to evaluate postural instability, Use of the retropulsion test includes a rapid balance perturbation in the backward direction, and the number of balance correcting steps (or total absence thereof) is used to rate the degree of postural instability. Healthy subjects correct such perturbations with either one or two large steps, or without taking any steps, hinging rapidly at the hips while swinging the arms forward as a counterweight. In patients with balance impairment, balance correcting steps are often too small, forcing patients to take more than two steps. Taking three or more steps is generally considered to be abnormal, and taking more than five steps is regarded as being clearly abnormal. Markedly affected patients continue to step backward without ever regaining their balance and must be caught by the examiner (this would be called true retropulsion). Even more severely affected patients fail to correct entirely, and fall backward like a pushed toy soldier, without taking any corrective steps. Evidence: TAS. Frequency: Frequent (HP:0040282). (ORPHA:2828)
- Dyskinesia (HP:0100660): A movement disorder which consists of effects including diminished voluntary movements and the presence of involuntary movements. Evidence: TAS. Frequency: Frequent (HP:0040282). (ORPHA:2828)
- Color vision defect (HP:0000551): An anomaly in the ability to discriminate between or recognize colors. Evidence: TAS. Frequency: Occasional (HP:0040283). (ORPHA:2828)
- Dementia (HP:0000726): A loss of global cognitive ability of sufficient amount to interfere with normal social or occupational function. Dementia represents a loss of previously present cognitive abilities, generally in adults, and can affect memory, thinking, language, judgment, and behavior. Evidence: TAS. Frequency: Occasional (HP:0040283). (ORPHA:2828)
- Short attention span (HP:0000736): Reduced attention span characterized by distractibility and impulsivity. Evidence: TAS. Frequency: Occasional (HP:0040283). (ORPHA:2828)
- Anxiety (HP:0000739): Intense feelings of nervousness, tension, or panic often arise in response to interpersonal stresses. There is worry about the negative effects of past unpleasant experiences and future negative possibilities. Individuals may feel fearful, apprehensive, or threatened by uncertainty, and they may also have fears of falling apart or losing control. Evidence: TAS. Frequency: Occasional (HP:0040283). (ORPHA:2828)
- Spasticity (HP:0001257): A motor disorder characterized by a velocity-dependent increase in tonic stretch reflexes with increased muscle tone, exaggerated (hyperexcitable) tendon reflexes. Evidence: TAS. Frequency: Occasional (HP:0040283). (ORPHA:2828)
- Dystonia (HP:0001332): An abnormally increased muscular tone that causes fixed abnormal postures. There is a slow, intermittent twisting motion that leads to exaggerated turning and posture of the extremities and trunk. Evidence: TAS. Frequency: Occasional (HP:0040283). (ORPHA:2828)
- Hyperreflexia (HP:0001347): Hyperreflexia is the presence of hyperactive stretch reflexes of the muscles. Evidence: TAS. Frequency: Occasional (HP:0040283). (ORPHA:2828)
- Diarrhea (HP:0002014): Abnormally increased frequency (usually defined as three or more) loose or watery bowel movements a day. Evidence: TAS. Frequency: Occasional (HP:0040283). (ORPHA:2828)
- Nausea (HP:0002018): A sensation of unease in the stomach together with an urge to vomit. Evidence: TAS. Frequency: Occasional (HP:0040283). (ORPHA:2828)
- Constipation (HP:0002019): Infrequent or difficult evacuation of feces. Evidence: TAS. Frequency: Occasional (HP:0040283). (ORPHA:2828)
- Bradykinesia (HP:0002067): Bradykinesia literally means slow movement, and is used clinically to denote a slowness in the execution of movement (in contrast to hypokinesia, which is used to refer to slowness in the initiation of movement). Evidence: TAS. Frequency: Occasional (HP:0040283). (ORPHA:2828)
- Gait imbalance (HP:0002141). Evidence: TAS. Frequency: Occasional (HP:0040283). (ORPHA:2828)
- Gastroparesis (HP:0002578): Decreased strength of the muscle layer of stomach, which leads to a decreased ability to empty the contents of the stomach despite the absence of obstruction. Evidence: TAS. Frequency: Occasional (HP:0040283). (ORPHA:2828)
- Muscle spasm (HP:0003394): Sudden and involuntary contractions of one or more muscles. Evidence: TAS. Frequency: Occasional (HP:0040283). (ORPHA:2828)
- Hyposmia (HP:0004409): A decreased sensitivity to odorants (that is, a decreased ability to perceive odors). Evidence: TAS. Frequency: Occasional (HP:0040283). (ORPHA:2828)
- Abnormal autonomic nervous system physiology (HP:0012332): A functional abnormality of the autonomic nervous system. Evidence: TAS. Frequency: Occasional (HP:0040283). (ORPHA:2828)
- Restless legs (HP:0012452): An irresistible urge to move the legs, usually accompanied by unpleasant sensations deep within the limbs. Symptoms typically begin or worsen during periods of rest or inactivity, are most pronounced in the evening or at night, and are temporarily relieved by movement such as walking or stretching. The disturbance often interferes with the initiation or maintenance of sleep. Evidence: TAS. Frequency: Occasional (HP:0040283). (ORPHA:2828)
- Panic attack (HP:0025269): A sudden episode of intense fear in a situation where there is no danger or apparent cause. Evidence: TAS. Frequency: Occasional (HP:0040283). (ORPHA:2828)
- Female sexual dysfunction (HP:0030014): A problem occurring during any phase of the female sexual response cycle that prevents the individual from experiencing satisfaction from the sexual activity. Evidence: TAS. Frequency: Occasional (HP:0040283). (ORPHA:2828)
- Male sexual dysfunction (HP:0040307): A problem occurring during any phase of the male sexual response cycle that prevents the individual from experiencing satisfaction from the sexual activity. Evidence: TAS. Frequency: Occasional (HP:0040283). (ORPHA:2828)
- Cognitive impairment (HP:0100543): Abnormal cognition is characterized by deficits in thinking, reasoning, or remembering. Evidence: TAS. Frequency: Occasional (HP:0040283). (ORPHA:2828)
- Insomnia (HP:0100785): Persistent difficulty in starting or maintaining sleep, or waking up earlier than desired, despite having adequate opportunities and conditions for sleep. Evidence: TAS. Frequency: Occasional (HP:0040283). (ORPHA:2828)
- Diplopia (HP:0000651): Diplopia is a condition in which a single object is perceived as two images, it is also known as double vision. Evidence: TAS. Frequency: Very rare (HP:0040284). (ORPHA:2828)
- Agitation (HP:0000713): A state of excessive motor activity that is associated with mental distress or a feeling of substantial unease or inner tension. Distinguished from restlessness by the increased level of emotional distress and negative intensity of the experience. Agitation has a significant level of physical activity that is typically threatening to the self or others. Evidence: TAS. Frequency: Very rare (HP:0040284). (ORPHA:2828)
- Frontal lobe dementia (HP:0000727). Evidence: TAS. Frequency: Very rare (HP:0040284). (ORPHA:2828)
- Impulsivity (HP:0100710): Acting on the spur of the moment or on a momentary basis without consideration of outcomes; having difficulty establishing or following plans; experiencing a sense of urgency and engaging in behavior that is uninhibited, cannot be inhibited, and is uncontrolled. The possibility of repression is inconceivable. Evidence: TAS. Frequency: Very rare (HP:0040284). (ORPHA:2828)
These phenotypes are associated with the disease Young-onset Parkinson disease (ORPHA:2828).